Phenotypes associated with the disease chromosome 22q11.2 deletion syndrome, distal (DECIPHER:72):
- Short stature (HP:0004322): A height below that which is expected according to age and gender norms. Although there is no universally accepted definition of short stature, many refer to "short stature" as height more than 2 standard deviations below the mean for age and gender (or below the 3rd percentile for age and gender dependent norms). Evidence: IEA. (DECIPHER:72)
- Abnormality of the face (HP:0000271): An abnormality of the face. Evidence: IEA. (DECIPHER:72)
- Small for gestational age (HP:0001518): Smaller than normal size according to sex and gestational age related norms, defined as a weight below the 10th percentile for the gestational age. Evidence: IEA. (DECIPHER:72)
- Intellectual disability (HP:0001249): The term intellectual disability or intellectual developmental disorder is used to describe significantly sub-average intellectual and adaptive functioning based on clinical assessment and as measured by individually administered, appropriately normed, standardized and validated tests of intellectual functioning and adaptive behavior, with onset during the developmental period from infancy through adolescence. Evidence: IEA. (DECIPHER:72)